Phenotypes associated with the disease hereditary spherocytosis type 3 (OMIM:270970):
- Spherocytosis (HP:0004444): The presence of erythrocytes that are sphere-shaped. Evidence: TAS. (OMIM:270970)
- Hemolytic anemia (HP:0001878): A type of anemia caused by premature destruction of red blood cells (hemolysis). Evidence: TAS. (OMIM:270970)
- Autosomal recessive inheritance (HP:0000007): A mode of inheritance that is observed for traits related to a gene encoded on one of the autosomes (i.e., the human chromosomes 1-22) in which a trait manifests in individuals with two pathogenic alleles, either homozygotes (two copies of the same mutant allele) or compound heterozygotes (whereby each copy of a gene has a distinct mutant allele). Evidence: TAS. (OMIM:270970)